- Vomiting (HP:0002013): Forceful ejection of the contents of the stomach through the mouth by means of a series of involuntary spasmic contractions. Evidence: IEA. (OMIM:610209)
- Migraine with aura (HP:0002077): A type of migraine in which there is an aura characterized by focal neurological phenomena that usually proceed, but may accompany or occur in the absence of, the headache. The symptoms of an aura may include fully reversible visual, sensory, and speech symptoms but not motor weakness. Visual symptoms may include flickering lights, spots and lines and/or loss of vision and/or unilateral sensory symptoms such as paresthesias or numbness. At least one of the symptoms of an aura develops gradually over 5 or more minutes and/or different symptoms occur in succession. Evidence: IEA. (OMIM:610209)
- Photophobia (HP:0000613): Excessive sensitivity to light with the sensation of discomfort or pain in the eyes due to exposure to bright light. Evidence: IEA. (OMIM:610209)
- Migraine without aura (HP:0002083): Repeated headache attacks lasting 4-72 h fulfilling at least two of the following criteria: 1) unilateral location, 2) pulsating quality, 3) moderate or severe pain intensity, and 4) aggravation by or causing avoidance of routine physical activity such as climbing stairs. Headache attacks are commonly accompanied by nausea, vomiting, photophobia, or phonophobia. Evidence: IEA. (OMIM:610209)
- Phonophobia (HP:0002183): An abnormally heightened sensitivity to loud sounds. Evidence: IEA. (OMIM:610209)
- Nausea (HP:0002018): A sensation of unease in the stomach together with an urge to vomit. Evidence: IEA. (OMIM:610209)
- Autosomal dominant inheritance (HP:0000006): A mode of inheritance that is observed for traits related to a gene encoded on one of the autosomes (i.e., the human chromosomes 1-22) in which a trait manifests in heterozygotes. In the context of medical genetics, an autosomal dominant disorder is caused when a single copy of the mutant allele is present. Males and females are affected equally, and can both transmit the disorder with a risk of 50% for each child of inheriting the mutant allele. Evidence: IEA. (OMIM:610209)
These phenotypes are associated with the disease migraine with or without aura, susceptibility to, 11 (OMIM:610209).